Phenotypes associated with the disease myopia 18, autosomal recessive (OMIM:255500):
- Autosomal recessive inheritance (HP:0000007): A mode of inheritance that is observed for traits related to a gene encoded on one of the autosomes (i.e., the human chromosomes 1-22) in which a trait manifests in individuals with two pathogenic alleles, either homozygotes (two copies of the same mutant allele) or compound heterozygotes (whereby each copy of a gene has a distinct mutant allele). Evidence: IEA. (OMIM:255500)
- Myopia (HP:0000545): An abnormality of refraction characterized by the ability to see objects nearby clearly, while objects in the distance appear blurry. Evidence: IEA. (OMIM:255500)